- Epistaxis (HP:0000421): Epistaxis, or nosebleed, refers to a hemorrhage localized in the nose. Evidence: IEA. (OMIM:132500)
- Autosomal dominant inheritance (HP:0000006): A mode of inheritance that is observed for traits related to a gene encoded on one of the autosomes (i.e., the human chromosomes 1-22) in which a trait manifests in heterozygotes. In the context of medical genetics, an autosomal dominant disorder is caused when a single copy of the mutant allele is present. Males and females are affected equally, and can both transmit the disorder with a risk of 50% for each child of inheriting the mutant allele. Evidence: IEA. (OMIM:132500)
These phenotypes are associated with the disease Epistaxis, hereditary (OMIM:132500).